Phenotypes associated with the disease X-linked intellectual disability, Schimke type (ORPHA:85285):
- Hearing impairment (HP:0000365): A decreased magnitude of the sensory perception of sound. Evidence: TAS. Frequency: Frequent (HP:0040282). (ORPHA:85285)
- External ophthalmoplegia (HP:0000544): Paralysis of the external ocular muscles. Evidence: TAS. Frequency: Frequent (HP:0040282). (ORPHA:85285)
- Intellectual disability (HP:0001249): The term intellectual disability or intellectual developmental disorder is used to describe significantly sub-average intellectual and adaptive functioning based on clinical assessment and as measured by individually administered, appropriately normed, standardized and validated tests of intellectual functioning and adaptive behavior, with onset during the developmental period from infancy through adolescence. Evidence: TAS. Frequency: Frequent (HP:0040282). (ORPHA:85285)
- Spasticity (HP:0001257): A motor disorder characterized by a velocity-dependent increase in tonic stretch reflexes with increased muscle tone, exaggerated (hyperexcitable) tendon reflexes. Evidence: TAS. Frequency: Frequent (HP:0040282). (ORPHA:85285)
- Global developmental delay (HP:0001263): A delay in the achievement of motor or mental milestones in the domains of development of a child, including motor skills, speech and language, cognitive skills, and social and emotional skills. This term should only be used to describe children younger than five years of age. Evidence: TAS. Frequency: Frequent (HP:0040282). (ORPHA:85285)
- Choreoathetosis (HP:0001266): Involuntary movements characterized by both athetosis (inability to sustain muscles in a fixed position) and chorea (widespread jerky arrhythmic movements). Evidence: TAS. Frequency: Frequent (HP:0040282). (ORPHA:85285)
- Absent speech (HP:0001344): Complete lack of development of speech and language abilities. Evidence: TAS. Frequency: Frequent (HP:0040282). (ORPHA:85285)
- Failure to thrive in infancy (HP:0001531). Evidence: TAS. Frequency: Frequent (HP:0040282). (ORPHA:85285)
- Poor suck (HP:0002033): An inadequate sucking reflex, resulting in the difficult of newborns to be breast-fed. Evidence: TAS. Frequency: Frequent (HP:0040282). (ORPHA:85285)
- Poor head control (HP:0002421): Difficulty to maintain correct position of the head while standing or sitting. Infant head lag is observed when the head seems to flop around or lags posteriorly behind the trunk. Several articles have maintained that head lag should be absent by age 3 to 4 months. Evidence: TAS. Frequency: Frequent (HP:0040282). (ORPHA:85285)
- Short stature (HP:0004322): A height below that which is expected according to age and gender norms. Although there is no universally accepted definition of short stature, many refer to "short stature" as height more than 2 standard deviations below the mean for age and gender (or below the 3rd percentile for age and gender dependent norms). Evidence: TAS. Frequency: Frequent (HP:0040282). (ORPHA:85285)
- Secondary microcephaly (HP:0005484): Head circumference which falls below 2 standard deviations below the mean for age and gender because of insufficient head growth after birth. Evidence: TAS. Frequency: Frequent (HP:0040282). (ORPHA:85285)
- Floppy infant (HP:0008947): Floppiness/hypotonia is defined as reduced resistance to passive movement of joints. Physical examination of floppy/hypotonic infants shows head lag, lack of shoulder and elbow muscle contraction on traction response, inability to tighten the shoulder girdle muscles (or slipping through) when held under the axillae, scarf sign (when the arm is pulled to the opposite side, the arm wraps around the neck with the elbow crossing midline), hyperdorsiflexion of the feet, easy apposition of the thumb against the forearm, feet touching the cheek with ease and without discomfort, frog leg position, and inverted U sign on ventral suspension (head, arms, and legs hanging down without elbow or knee flexion and the trunk rounded in a dome shape). Evidence: TAS. Frequency: Frequent (HP:0040282). (ORPHA:85285)
- Dyskinesia (HP:0100660): A movement disorder which consists of effects including diminished voluntary movements and the presence of involuntary movements. Evidence: TAS. Frequency: Frequent (HP:0040282). (ORPHA:85285)
- Vesicoureteral reflux (HP:0000076): Abnormal (retrograde) movement of urine from the bladder into ureters or kidneys related to inadequacy of the valvular mechanism at the ureterovesicular junction or other causes. Evidence: TAS. Frequency: Occasional (HP:0040283). (ORPHA:85285)
- Hydronephrosis (HP:0000126): Severe distention of the kidney with dilation of the renal pelvis and calices. Evidence: TAS. Frequency: Occasional (HP:0040283). (ORPHA:85285)
- High palate (HP:0000218): Height of the palate more than 2 SD above the mean (objective) or palatal height at the level of the first permanent molar more than twice the height of the teeth (subjective). Evidence: TAS. Frequency: Occasional (HP:0040283). (ORPHA:85285)
- Narrow nasal bridge (HP:0000446): Decreased width of the bony bridge of the nose. Evidence: TAS. Frequency: Occasional (HP:0040283). (ORPHA:85285)
- Deeply set eye (HP:0000490): An eye that is more deeply recessed into the plane of the face than is typical. Evidence: TAS. Frequency: Occasional (HP:0040283). (ORPHA:85285)
- Hyperreflexia (HP:0001347): Hyperreflexia is the presence of hyperactive stretch reflexes of the muscles. Evidence: TAS. Frequency: Occasional (HP:0040283). (ORPHA:85285)
- Cerebral cortical atrophy (HP:0002120): Atrophy of the cortex of the cerebrum. Evidence: TAS. Frequency: Occasional (HP:0040283). (ORPHA:85285)
- Elbow flexion contracture (HP:0002987): An elbow contracture that limits the ability of the elbow joint to be extended (straightened), meaning that the elbow is fixed in an flexed (bent) position. Evidence: TAS. Frequency: Occasional (HP:0040283). (ORPHA:85285)
- Hip contracture (HP:0003273): Lack of full passive range of motion (restrictions in flexion, extension, or other movements) of the hip joint resulting from structural changes of non-bony tissues, such as muscles, tendons, ligaments, joint capsules and/or skin. Evidence: TAS. Frequency: Occasional (HP:0040283). (ORPHA:85285)
- Knee flexion contracture (HP:0006380): A type of knee joint contracture in which the knee is in a fixed bent (flexed) configuration such that it cannot be straightened actively or passively. Evidence: TAS. Frequency: Occasional (HP:0040283). (ORPHA:85285)
- Ankle flexion contracture (HP:0006466). Evidence: TAS. Frequency: Occasional (HP:0040283). (ORPHA:85285)
- Gastrostomy tube feeding in infancy (HP:0011471): Feeding problem necessitating gastrostomy tube feeding. Evidence: TAS. Frequency: Occasional (HP:0040283). (ORPHA:85285)